- Lipoatrophy (HP:0100578): Localized loss of fat tissue. Evidence: TAS. Frequency: Obligate (HP:0040280). (ORPHA:90159)
- Reduced subcutaneous adipose tissue (HP:0003758): A reduced amount of fat tissue in the lowest layer of the integument. This feature can be appreciated by a reduced skinfold thickness. Evidence: TAS. Frequency: Very frequent (HP:0040281). (ORPHA:90159)
- Absence of subcutaneous fat (HP:0007485): Lack of subcutaneous adipose tissue. Evidence: TAS. Frequency: Frequent (HP:0040282). (ORPHA:90159)
- Abnormal circulating immunoglobulin concentration (HP:0010701): An abnormal deviation from normal levels of immunoglobulins in blood. Evidence: TAS. Frequency: Frequent (HP:0040282). (ORPHA:90159)
- Erythema (HP:0010783): Redness of the skin, caused by hyperemia of the capillaries in the lower layers of the skin. Evidence: TAS. Frequency: Frequent (HP:0040282). (ORPHA:90159)
- Inflammatory abnormality of the skin (HP:0011123): The presence of inflammation of the skin. That is, an abnormality of the skin resulting from the local accumulation of fluid, plasma proteins, and leukocytes. Evidence: TAS. Frequency: Frequent (HP:0040282). (ORPHA:90159)
- Skin nodule (HP:0200036): Morphologically similar to a papule, but greater than either 10mm in both width and depth, and most frequently centered in the dermis or subcutaneous fat. Evidence: TAS. Frequency: Frequent (HP:0040282). (ORPHA:90159)
- Antinuclear antibody positivity (HP:0003493): The presence of autoantibodies in the serum that react against nuclei or nuclear components. Evidence: TAS. Frequency: Occasional (HP:0040283). (ORPHA:90159)
- Vasculitis in the skin (HP:0200029): A type of vasculitis (inflammation of blood vessel walls) that affects skeletal muscle tissue. Evidence: TAS. Frequency: Occasional (HP:0040283). (ORPHA:90159)
These phenotypes are associated with the disease Panniculitis-induced localized lipodystrophy (ORPHA:90159).